- Facial asymmetry (HP:0000324): An abnormal difference between the left and right sides of the face. Evidence: TAS. Frequency: Occasional (HP:0040283). (ORPHA:1955)
- Strabismus (HP:0000486): A misalignment of the eyes so that the visual axes deviate from bifoveal fixation. The classification of strabismus may be based on a number of features including the relative position of the eyes, whether the deviation is latent or manifest, intermittent or constant, concomitant or otherwise and according to the age of onset and the relevance of any associated refractive error. Evidence: TAS. Frequency: Occasional (HP:0040283). (ORPHA:1955)
- Nystagmus (HP:0000639): Rhythmic, involuntary oscillations of one or both eyes related to abnormality in fixation, conjugate gaze, or vestibular mechanisms. Evidence: TAS. Frequency: Very frequent (HP:0040281). (ORPHA:1955)
- Dry skin (HP:0000958): Skin characterized by the lack of natural or normal moisture. Evidence: TAS. Frequency: Very frequent (HP:0040281). (ORPHA:1955)
- Hypohidrosis (HP:0000966): Abnormally diminished capacity to sweat. Evidence: TAS. Frequency: Very frequent (HP:0040281). (ORPHA:1955)
- Urticaria (HP:0001025): Raised, well-circumscribed areas of erythema and edema involving the dermis and epidermis. Urticaria is intensely pruritic, and blanches completely with pressure. Evidence: TAS. Frequency: Very frequent (HP:0040281). (ORPHA:1955)
- Dysarthria (HP:0001260): Dysarthric speech is a general description referring to a neurological speech disorder characterized by poor articulation. Depending on the involved neurological structures, dysarthria may be further classified as spastic, flaccid, ataxic, hyperkinetic and hypokinetic, or mixed. Evidence: TAS. Frequency: Very frequent (HP:0040281). (ORPHA:1955)
- Hyporeflexia (HP:0001265): Reduction of neurologic reflexes such as the knee-jerk reaction. Evidence: TAS. Frequency: Very frequent (HP:0040281). (ORPHA:1955)
- Gait disturbance (HP:0001288): The term gait disturbance can refer to any disruption of the ability to walk. Evidence: TAS. Frequency: Very frequent (HP:0040281). (ORPHA:1955)
- Progressive cerebellar ataxia (HP:0002073). Evidence: TAS. Frequency: Very frequent (HP:0040281). (ORPHA:1955)
- Dysdiadochokinesis (HP:0002075): A type of ataxia characterized by the impairment of the ability to perform rapidly alternating movements, such as pronating and supinating his or her hand on the dorsum of the other hand as rapidly as possible. Evidence: TAS. Frequency: Very frequent (HP:0040281). (ORPHA:1955)
- Abnormal speech pattern (HP:0002167): An abnormality in the sound (volume) or cadence (rate) of speech. Evidence: TAS. Frequency: Very frequent (HP:0040281). (ORPHA:1955)
- Abnormality of the musculature (HP:0003011): Abnormality originating in one or more muscles, i.e., of the set of muscles of body. Evidence: TAS. Frequency: Occasional (HP:0040283). (ORPHA:1955)
- Macule (HP:0012733): A flat, distinct, discolored area of skin less than 1 cm wide that does not involve any change in the thickness or texture of the skin. Evidence: TAS. Frequency: Very frequent (HP:0040281). (ORPHA:1955)
- Abnormality of movement (HP:0100022): An abnormality of movement with a neurological basis characterized by changes in coordination and speed of voluntary movements. Evidence: TAS. Frequency: Frequent (HP:0040282). (ORPHA:1955)
- Papule (HP:0200034): A circumscribed, solid elevation of skin with no visible fluid, varying in size from a pinhead to less than 10mm in diameter at the widest point. Evidence: TAS. Frequency: Very frequent (HP:0040281). (ORPHA:1955)
These phenotypes are associated with the disease Spinocerebellar ataxia type 34 (ORPHA:1955).